- Autoimmune antibody positivity (HP:0030057): The presence of an antibody in the blood circulation that is directed against the organism's own cells or tissues. Evidence: TAS. (OMIM:140300)
- Hashimoto thyroiditis (HP:0000872): A chronic, autoimmune type of thyroiditis associated with hypothyroidism. Evidence: TAS. (OMIM:140300)
- Autosomal dominant inheritance (HP:0000006): A mode of inheritance that is observed for traits related to a gene encoded on one of the autosomes (i.e., the human chromosomes 1-22) in which a trait manifests in heterozygotes. In the context of medical genetics, an autosomal dominant disorder is caused when a single copy of the mutant allele is present. Males and females are affected equally, and can both transmit the disorder with a risk of 50% for each child of inheriting the mutant allele. Evidence: TAS. (OMIM:140300)
These phenotypes are associated with the disease Hashimoto thyroiditis (OMIM:140300).